Phenotypes associated with the disease carpal tunnel syndrome 1 (OMIM:115430):
- Digital flexor tenosynovitis (HP:0012276): Inflammation of the flexor digitorum tendon, often associated with the Kanavel signs: (i) finger held in slight flexion, (ii) fusiform swelling, (iii) tenderness along the flexor tendon sheath, and (iv) pain with passive extension of the digit. Evidence: TAS. (OMIM:115430)
- Constrictive median neuropathy (HP:0012185): Injury to the median nerve caused by its entrapment at the wrist as it traverses through the carpal tunnel. Clinically, constrictive median neuropathy is characterized by pain, paresthesia, and weakness in the median nerve distribution of the hand. Evidence: TAS. (OMIM:115430)
- Peripheral neuropathy (HP:0009830): Peripheral neuropathy is a general term for any disorder of the peripheral nervous system. The main clinical features used to classify peripheral neuropathy are distribution, type (mainly demyelinating versus mainly axonal), duration, and course. Evidence: IEA. (OMIM:115430)
- Reduced circulating vitamin B6 circulating (HP:0008326): An abnormally decreased concentration of vitamin B6 in the blood circulation. Evidence: IEA. (OMIM:115430)
- Autosomal dominant inheritance (HP:0000006): A mode of inheritance that is observed for traits related to a gene encoded on one of the autosomes (i.e., the human chromosomes 1-22) in which a trait manifests in heterozygotes. In the context of medical genetics, an autosomal dominant disorder is caused when a single copy of the mutant allele is present. Males and females are affected equally, and can both transmit the disorder with a risk of 50% for each child of inheriting the mutant allele. Evidence: IEA. (OMIM:115430)